Phenotypes associated with the disease intellectual disability, X-linked 72 (OMIM:300271):
- Long face (HP:0000276): Facial height (length) is more than 2 standard deviations above the mean (objective); or, an apparent increase in the height (length) of the face (subjective). Evidence: IEA. (OMIM:300271)
- Short stature (HP:0004322): A height below that which is expected according to age and gender norms. Although there is no universally accepted definition of short stature, many refer to "short stature" as height more than 2 standard deviations below the mean for age and gender (or below the 3rd percentile for age and gender dependent norms). Evidence: PCS. Frequency: 4/9. (PMID:20159109)
- Seizure (HP:0001250): A seizure is an intermittent abnormality of nervous system physiology characterized by a transient occurrence of signs and/or symptoms due to abnormal excessive or synchronous neuronal activity in the brain. Evidence: PCS. Frequency: 3/9. (PMID:20159109)
- X-linked recessive inheritance (HP:0001419): A mode of inheritance that is observed for recessive traits related to a gene encoded on the X chromosome. In the context of medical genetics, X-linked recessive disorders manifest in males (who have one copy of the X chromosome and are thus hemizygotes), but generally not in female heterozygotes who have one mutant and one normal allele. Evidence: PCS. (PMID:20159109)
- Global developmental delay (HP:0001263): A delay in the achievement of motor or mental milestones in the domains of development of a child, including motor skills, speech and language, cognitive skills, and social and emotional skills. This term should only be used to describe children younger than five years of age. Evidence: PCS. (PMID:20159109)
- Autistic behavior (HP:0000729): Persistent deficits in social interaction and communication and interaction as well as a markedly restricted repertoire of activity and interest as well as repetitive patterns of behavior. Evidence: PCS. Frequency: 1/9. (PMID:20159109)
- Motor stereotypy (HP:0000733): Use of the same abnormal action in response to certain triggers or at random. They may be used as a way to regulate one's internal state but must otherwise have no apparent functional purpose. Evidence: IEA. (OMIM:300271)
- Dolichocephaly (HP:0000268): An abnormality of skull shape characterized by a increased anterior-posterior diameter, i.e., an increased antero-posterior dimension of the skull. Cephalic index less than 76%. Alternatively, an apparently increased antero-posterior length of the head compared to width. Often due to premature closure of the sagittal suture. Evidence: IEA. (OMIM:300271)
- Hyperactivity (HP:0000752): Hyperactivity is a condition characterized by constant and unusually high levels of activity, even in situations where it is deemed inappropriate. Evidence: IEA. (OMIM:300271)
- Macrocephaly (HP:0000256): Occipitofrontal (head) circumference greater than 97th centile compared to appropriate, age matched, sex-matched normal standards. Alternatively, a apparently increased size of the cranium. Evidence: PCS. Frequency: 6/9. (PMID:20159109)
- Intellectual disability (HP:0001249): The term intellectual disability or intellectual developmental disorder is used to describe significantly sub-average intellectual and adaptive functioning based on clinical assessment and as measured by individually administered, appropriately normed, standardized and validated tests of intellectual functioning and adaptive behavior, with onset during the developmental period from infancy through adolescence. Evidence: PCS. Frequency: 9/9. (PMID:20159109)